- Visual impairment (HP:0000505): Visual impairment (or vision impairment) is vision loss (of a person) to such a degree as to qualify as an additional support need through a significant limitation of visual capability resulting from either disease, trauma, or congenital or degenerative conditions that cannot be corrected by conventional means, such as refractive correction, medication, or surgery. Evidence: TAS. Frequency: Very frequent (HP:0040281). (ORPHA:1871)
- Abnormal electroretinogram (HP:0000512): Any abnormality of the electrical responses of various cell types in the retina as measured by electroretinography. Evidence: TAS. Frequency: Very frequent (HP:0040281). (ORPHA:1871)
- Color vision defect (HP:0000551): An anomaly in the ability to discriminate between or recognize colors. Evidence: TAS. Frequency: Very frequent (HP:0040281). (ORPHA:1871)
- Photophobia (HP:0000613): Excessive sensitivity to light with the sensation of discomfort or pain in the eyes due to exposure to bright light. Evidence: TAS. Frequency: Very frequent (HP:0040281). (ORPHA:1871)
- Abnormal retinal pigmentation (HP:0007703): Any deviation from the normal pigmentation of the retina. Evidence: TAS. Frequency: Very frequent (HP:0040281). (ORPHA:1871)
These phenotypes are associated with the disease Progressive cone dystrophy (ORPHA:1871).